Phenotypes associated with the disease fused mandibular incisors (OMIM:147251, an entry in Online Mendelian Inheritance in Man):
- Abnormality of the dentition (HP:0000164, a Human Phenotype Ontology term): Any abnormality of the teeth. Evidence: IEA. (OMIM:147251)
- Autosomal dominant inheritance (HP:0000006, a Human Phenotype Ontology term): A mode of inheritance that is observed for traits related to a gene encoded on one of the autosomes (i.e., the human chromosomes 1-22) in which a trait manifests in heterozygotes. In the context of medical genetics, an autosomal dominant disorder is caused when a single copy of the mutant allele is present. Males and females are affected equally, and can both transmit the disorder with a risk of 50% for each child of inheriting the mutant allele. Evidence: IEA. (OMIM:147251)